- Abnormal rib morphology (HP:0000772): An anomaly of the rib. Evidence: TAS. Frequency: Occasional (HP:0040283). (ORPHA:1120)
- Congenital diaphragmatic hernia (HP:0000776): The presence of a hernia of the diaphragm present at birth. Evidence: TAS. Frequency: Occasional (HP:0040283). (ORPHA:1120)
- Abnormal thumb morphology (HP:0001172): An abnormal structure of the first digit of the hand. Evidence: TAS. Frequency: Occasional (HP:0040283). (ORPHA:1120)
- Preaxial hand polydactyly (HP:0001177): Supernumerary digits located at the radial side of the hand. Polydactyly (supernumerary digits) involving the thumb occurs in many distinct forms of high variability and severity. Ranging from fleshy nubbins over varying degrees of partial duplication/splitting to completely duplicated or even triplicated thumbs or preaxial (on the radial side of the hand) supernumerary digits. Evidence: TAS. Frequency: Occasional (HP:0040283). (ORPHA:1120)
- Triphalangeal thumb (HP:0001199): A thumb with three phalanges in a single, proximo-distal axis. Thus, this term applies if the thumb has an accessory phalanx, leading to a digit like appearance of the thumb. Evidence: TAS. Frequency: Occasional (HP:0040283). (ORPHA:1120)
- Seizure (HP:0001250): A seizure is an intermittent abnormality of nervous system physiology characterized by a transient occurrence of signs and/or symptoms due to abnormal excessive or synchronous neuronal activity in the brain. Evidence: TAS. Frequency: Occasional (HP:0040283). (ORPHA:1120)
- Death in infancy (HP:0001522): Death within the first 24 months of life. Evidence: TAS. Frequency: Frequent (HP:0040282). (ORPHA:1120)
- Atrial septal defect (HP:0001631): Atrial septal defect (ASD) is a congenital abnormality of the interatrial septum that enables blood flow between the left and right atria via the interatrial septum. Evidence: TAS. Frequency: Frequent (HP:0040282). (ORPHA:1120)
- Patent ductus arteriosus (HP:0001643): In utero, the ductus arteriosus (DA) serves to divert ventricular output away from the lungs and toward the placenta by connecting the main pulmonary artery to the descending aorta. A patent ductus arteriosus (PDA) in the first 3 days of life is a physiologic shunt in healthy term and preterm newborn infants, and normally is substantially closed within about 24 hours after bith and completely closed after about three weeks. Failure of physiologcal closure is referred to a persistent or patent ductus arteriosus (PDA). Depending on the degree of left-to-right shunting, PDA can have clinical consequences. Evidence: TAS. Frequency: Frequent (HP:0040282). (ORPHA:1120)
- Abnormal aortic valve morphology (HP:0001646): Any abnormality of the aortic valve. Evidence: TAS. Frequency: Occasional (HP:0040283). (ORPHA:1120)
- Bicuspid aortic valve (HP:0001647): The presence of an aortic valve with two instead of the normal three cusps (flaps). Bicuspid aortic valvue is a malformation of a commissure (small space between the attachment of each cusp to the aortic wall) and the adjacent parts of the two corresponding cusps forming a raphe (the fused area of the two underdeveloped cusps turning into a malformed commissure between both cusps; the raphe is a fibrous ridge that extends from the commissure to the free edge of the two underdeveloped, conjoint cusps). Evidence: TAS. Frequency: Occasional (HP:0040283). (ORPHA:1120)
- Coarctation of aorta (HP:0001680): Coarctation of the aorta is a narrowing or constriction of a segment of the aorta. Evidence: TAS. Frequency: Frequent (HP:0040282). (ORPHA:1120)
- Talipes equinovalgus (HP:0001772): A deformity of foot and ankle in which the foot is bent down and outwards. Evidence: TAS. Frequency: Occasional (HP:0040283). (ORPHA:1120)
- Respiratory insufficiency (HP:0002093). Evidence: TAS. Frequency: Very frequent (HP:0040281). (ORPHA:1120)
- Abnormal lung lobation (HP:0002101): A developmental defect in the formation of pulmonary lobes. Evidence: TAS. Frequency: Frequent (HP:0040282). (ORPHA:1120)
- Ventriculomegaly (HP:0002119): An increase in size of the ventricular system of the brain. Evidence: TAS. Frequency: Occasional (HP:0040283). (ORPHA:1120)
- Spina bifida (HP:0002414): Incomplete closure of the embryonic neural tube, whereby some vertebral arches remain unfused and open. The mildest form is spina bifida occulta, followed by meningocele and meningomyelocele. Evidence: TAS. Frequency: Occasional (HP:0040283). (ORPHA:1120)
- Vertebral segmentation defect (HP:0003422): An abnormality related to a defect of vertebral separation during development. Evidence: TAS. Frequency: Occasional (HP:0040283). (ORPHA:1120)
- Tricuspid regurgitation (HP:0005180): Failure of the tricuspid valve to close sufficiently upon contraction of the right ventricle, causing blood to regurgitate (flow backward) into the right atrium. Evidence: TAS. Frequency: Occasional (HP:0040283). (ORPHA:1120)
- Atrioventricular canal defect (HP:0006695): A defect of the atrioventricular septum of the heart. Evidence: TAS. Frequency: Occasional (HP:0040283). (ORPHA:1120)
- Aplasia/Hypoplasia of the lungs (HP:0006703). Evidence: TAS. Frequency: Frequent (HP:0040282). (ORPHA:1120)
- Bilateral single transverse palmar creases (HP:0007598): The distal and proximal transverse palmar creases are merged into a single transverse palmar crease on both hands. Evidence: TAS. Frequency: Occasional (HP:0040283). (ORPHA:1120)
- Proximal placement of thumb (HP:0009623): Proximal mislocalization of the thumb. Evidence: TAS. Frequency: Occasional (HP:0040283). (ORPHA:1120)
- Short thumb (HP:0009778): Hypoplasia (congenital reduction in size) of the thumb. Evidence: TAS. Frequency: Occasional (HP:0040283). (ORPHA:1120)
- Short distal phalanx of finger (HP:0009882): Short distance from the end of the finger to the most distal interphalangeal crease or the distal interphalangeal joint flexion point. That is, hypoplasia of one or more of the distal phalanx of finger. Evidence: TAS. Frequency: Occasional (HP:0040283). (ORPHA:1120)
- Anomalous pulmonary venous return (HP:0010772): A developmental defect characterized by abnormal connection of one or more pulmonary veins to the superior or inferior vena cava, the right atrium, or the coronary sinus, resulting in a left-to-right shunt of oxygenated blood. Evidence: TAS. Frequency: Frequent (HP:0040282). (ORPHA:1120)
- Abnormal helix morphology (HP:0011039): An abnormality of the helix. The helix is the outer rim of the ear that extends from the insertion of the ear on the scalp (root) to the termination of the cartilage at the earlobe. Evidence: TAS. Frequency: Occasional (HP:0040283). (ORPHA:1120)
These phenotypes are associated with the disease Lung agenesis-heart defect-thumb anomalies syndrome (ORPHA:1120).